Phenotypes associated with the disease MAN1B1-CDG (ORPHA:397941):
- Intellectual disability (HP:0001249): The term intellectual disability or intellectual developmental disorder is used to describe significantly sub-average intellectual and adaptive functioning based on clinical assessment and as measured by individually administered, appropriately normed, standardized and validated tests of intellectual functioning and adaptive behavior, with onset during the developmental period from infancy through adolescence. Evidence: TAS. Frequency: Very frequent (HP:0040281). (ORPHA:397941)
- Global developmental delay (HP:0001263): A delay in the achievement of motor or mental milestones in the domains of development of a child, including motor skills, speech and language, cognitive skills, and social and emotional skills. This term should only be used to describe children younger than five years of age. Evidence: TAS. Frequency: Very frequent (HP:0040281). (ORPHA:397941)
- Abnormal facial shape (HP:0001999): An abnormal morphology (form) of the face or its components. Evidence: TAS. Frequency: Very frequent (HP:0040281). (ORPHA:397941)
- Floppy infant (HP:0008947): Floppiness/hypotonia is defined as reduced resistance to passive movement of joints. Physical examination of floppy/hypotonic infants shows head lag, lack of shoulder and elbow muscle contraction on traction response, inability to tighten the shoulder girdle muscles (or slipping through) when held under the axillae, scarf sign (when the arm is pulled to the opposite side, the arm wraps around the neck with the elbow crossing midline), hyperdorsiflexion of the feet, easy apposition of the thumb against the forearm, feet touching the cheek with ease and without discomfort, frog leg position, and inverted U sign on ventral suspension (head, arms, and legs hanging down without elbow or knee flexion and the trunk rounded in a dome shape). Evidence: TAS. Frequency: Very frequent (HP:0040281). (ORPHA:397941)
- Hypertelorism (HP:0000316): Interpupillary distance more than 2 SD above the mean (alternatively, the appearance of an increased interpupillary distance or widely spaced eyes). Evidence: TAS. Frequency: Frequent (HP:0040282). (ORPHA:397941)
- Low-set ears (HP:0000369): Upper insertion of the ear to the scalp below an imaginary horizontal line drawn between the inner canthi of the eye and extending posteriorly to the ear. Evidence: TAS. Frequency: Frequent (HP:0040282). (ORPHA:397941)
- Macrotia (HP:0000400): Median longitudinal ear length greater than two standard deviations above the mean and median ear width greater than two standard deviations above the mean (objective); or, apparent increase in length and width of the pinna (subjective). Evidence: TAS. Frequency: Frequent (HP:0040282). (ORPHA:397941)
- Downslanted palpebral fissures (HP:0000494): The palpebral fissure inclination is more than two standard deviations below the mean. Evidence: TAS. Frequency: Frequent (HP:0040282). (ORPHA:397941)
- Mild intellectual disability (HP:0001256): Mild intellectual disability (ID) is defined as a type of ID characterized by mildly sub-average adaptive functioning and intellectual functioning, with an intelligence quotient (IQ) the range of 50-69. Evidence: TAS. Frequency: Frequent (HP:0040282). (ORPHA:397941)
- Truncal obesity (HP:0001956): Obesity located preferentially in the trunk of the body as opposed to the extremities. Evidence: TAS. Frequency: Frequent (HP:0040282). (ORPHA:397941)
- Poor speech (HP:0002465). Evidence: TAS. Frequency: Frequent (HP:0040282). (ORPHA:397941)
- Type II transferrin isoform profile (HP:0012301): Abnormal transferrin isoform profile consistent with a type II congenital disorder of glycosylation. Evidence: TAS. Frequency: Frequent (HP:0040282). (ORPHA:397941)
- Abnormal brain morphology (HP:0012443): A structural abnormality of the brain, which has as its parts the forebrain, midbrain, and hindbrain. Evidence: TAS. Frequency: Frequent (HP:0040282). (ORPHA:397941)
- Thin upper lip vermilion (HP:0000219): Height of the vermilion of the upper lip in the midline more than 2 SD below the mean. Alternatively, an apparently reduced height of the vermilion of the upper lip in the frontal view (subjective). Evidence: TAS. Frequency: Occasional (HP:0040283). (ORPHA:397941)
- Dolichocephaly (HP:0000268): An abnormality of skull shape characterized by a increased anterior-posterior diameter, i.e., an increased antero-posterior dimension of the skull. Cephalic index less than 76%. Alternatively, an apparently increased antero-posterior length of the head compared to width. Often due to premature closure of the sagittal suture. Evidence: TAS. Frequency: Occasional (HP:0040283). (ORPHA:397941)
- Malar flattening (HP:0000272): Underdevelopment of the malar prominence of the jugal bone (zygomatic bone in mammals), appreciated in profile, frontal view, and/or by palpation. Evidence: TAS. Frequency: Occasional (HP:0040283). (ORPHA:397941)
- Pointed chin (HP:0000307): A marked tapering of the lower face to the chin. Evidence: TAS. Frequency: Occasional (HP:0040283). (ORPHA:397941)
- Smooth philtrum (HP:0000319): Flat skin surface, with no ridge formation in the central region of the upper lip between the nasal base and upper vermilion border. Evidence: TAS. Frequency: Occasional (HP:0040283). (ORPHA:397941)
- Short philtrum (HP:0000322): Distance between nasal base and midline upper lip vermilion border more than 2 SD below the mean. Alternatively, an apparently decreased distance between nasal base and midline upper lip vermilion border. Evidence: TAS. Frequency: Occasional (HP:0040283). (ORPHA:397941)
- Short chin (HP:0000331): Decreased vertical distance from the vermilion border of the lower lip to the inferior-most point of the chin. Evidence: TAS. Frequency: Occasional (HP:0040283). (ORPHA:397941)
- Wide nasal bridge (HP:0000431): Increased breadth of the nasal bridge (and with it, the nasal root). Evidence: TAS. Frequency: Occasional (HP:0040283). (ORPHA:397941)
- Wide nose (HP:0000445): Interalar distance more than two standard deviations above the mean for age, i.e., an apparently increased width of the nasal base and alae. Evidence: TAS. Frequency: Occasional (HP:0040283). (ORPHA:397941)
- Prominent nose (HP:0000448): Distance between subnasale and pronasale more than two standard deviations above the mean, or alternatively, an apparently increased anterior protrusion of the nasal tip. Evidence: TAS. Frequency: Occasional (HP:0040283). (ORPHA:397941)
- Short neck (HP:0000470): Diminished length of the neck. Evidence: TAS. Frequency: Occasional (HP:0040283). (ORPHA:397941)
- Hypermetropia (HP:0000540): An abnormality of refraction characterized by the ability to see objects in the distance clearly, while objects nearby appear blurry. Evidence: TAS. Frequency: Occasional (HP:0040283). (ORPHA:397941)
- Atypical behavior (HP:0000708): Atypical behavior is an abnormality in a person's actions that can be controlled or modulated by the will of the individual. While abnormal behaviors can be difficult to control, they are distinct from other abnormal actions that cannot be affected by the individual's will. Evidence: TAS. Frequency: Occasional (HP:0040283). (ORPHA:397941)
- Autism (HP:0000717): Autism is a neurodevelopmental disorder characterized by impaired social interaction and communication, and by restricted and repetitive behavior. Autism begins in childhood. It is marked by the presence of markedly abnormal or impaired development in social interaction and communication and a markedly restricted repertoire of activity and interest. Manifestations of the disorder vary greatly depending on the developmental level and chronological age of the individual (DSM-IV). Evidence: TAS. Frequency: Occasional (HP:0040283). (ORPHA:397941)
- Pectus carinatum (HP:0000768): A deformity of the chest caused by overgrowth of the ribs and characterized by protrusion of the sternum. Evidence: TAS. Frequency: Occasional (HP:0040283). (ORPHA:397941)
- Cutis laxa (HP:0000973): Wrinkled, redundant, inelastic and sagging skin. Evidence: TAS. Frequency: Occasional (HP:0040283). (ORPHA:397941)
- Seizure (HP:0001250): A seizure is an intermittent abnormality of nervous system physiology characterized by a transient occurrence of signs and/or symptoms due to abnormal excessive or synchronous neuronal activity in the brain. Evidence: TAS. Frequency: Occasional (HP:0040283). (ORPHA:397941)
- Cerebellar hypoplasia (HP:0001321): Cerebellar hypoplasia is a descriptive term implying a cerebellum with a reduced volume, but a normal shape and is stable over time. Evidence: TAS. Frequency: Occasional (HP:0040283). (ORPHA:397941)
- Joint hypermobility (HP:0001382): The capability that a joint (or a group of joints) has to move, passively and/or actively, beyond normal limits along physiological axes. Evidence: TAS. Frequency: Occasional (HP:0040283). (ORPHA:397941)
- Frontal bossing (HP:0002007): Bilateral bulging of the lateral frontal bone prominences with relative sparing of the midline. Evidence: TAS. Frequency: Occasional (HP:0040283). (ORPHA:397941)
- Broad-based gait (HP:0002136): An abnormal gait pattern in which persons stand and walk with their feet spaced widely apart. This is often a component of cerebellar ataxia. Evidence: TAS. Frequency: Occasional (HP:0040283). (ORPHA:397941)
- Moderate intellectual disability (HP:0002342): Moderate intellectual disability (ID) is defined as a type of ID characterized by moderately sub-average adaptive functioning and intellectual functioning, with an intelligence quotient (IQ) the range of 35-49. Evidence: TAS. Frequency: Occasional (HP:0040283). (ORPHA:397941)
- Polyphagia (HP:0002591): A neurological anomaly with gross overeating associated with an abnormally strong desire or need to eat. Evidence: TAS. Frequency: Occasional (HP:0040283). (ORPHA:397941)
- Inverted nipples (HP:0003186): The presence of nipples that instead of pointing outward are retracted inwards. Evidence: TAS. Frequency: Occasional (HP:0040283). (ORPHA:397941)
- Long eyebrows (HP:0004523): Increased length of the hairs of the eyebrows. Evidence: TAS. Frequency: Occasional (HP:0040283). (ORPHA:397941)
- Underdeveloped nasolabial fold (HP:0010801): Reduced bulkiness of the crease or fold of skin running from the lateral margin of the nose, where nasal base meets the skin of the face, to a point just lateral to the corner of the mouth (cheilion or commissure). Evidence: TAS. Frequency: Occasional (HP:0040283). (ORPHA:397941)
- Abnormal position of hair whorl (HP:0010814): Hair growth from a single point on the scalp in any location other than lateral to the midline and close to the vertex of the skull. Evidence: TAS. Frequency: Occasional (HP:0040283). (ORPHA:397941)
- Severe intellectual disability (HP:0010864): Severe intellectual disability (ID) is defined as a type of ID characterized by severely sub-average adaptive functioning and intellectual functioning, with an intelligence quotient (IQ) the range of 20-34. Evidence: TAS. Frequency: Occasional (HP:0040283). (ORPHA:397941)
- Sparse eyebrow (HP:0045075): Decreased density/number of eyebrow hairs. Evidence: TAS. Frequency: Occasional (HP:0040283). (ORPHA:397941)
- Long face (HP:0000276): Facial height (length) is more than 2 standard deviations above the mean (objective); or, an apparent increase in the height (length) of the face (subjective). Evidence: TAS. Frequency: Very rare (HP:0040284). (ORPHA:397941)
- Epicanthus (HP:0000286): A fold of skin starting above the medial aspect of the upper eyelid and arching downward to cover, pass in front of and lateral to the medial canthus. Evidence: TAS. Frequency: Very rare (HP:0040284). (ORPHA:397941)
- Long eyelashes (HP:0000527): Mid upper eyelash length >10 mm or increased length of the eyelashes (subjective). Evidence: TAS. Frequency: Very rare (HP:0040284). (ORPHA:397941)
- Resting tremor (HP:0002322): A resting tremor occurs when muscles are at rest and becomes less noticeable or disappears when the affected muscles are moved. Resting tremors are often slow and coarse. Evidence: TAS. Frequency: Very rare (HP:0040284). (ORPHA:397941)
- Clinodactyly of the 5th finger (HP:0004209): Clinodactyly refers to a bending or curvature of the fifth finger in the radial direction (i.e., towards the 4th finger). Evidence: TAS. Frequency: Very rare (HP:0040284). (ORPHA:397941)
- 2-3 toe syndactyly (HP:0004691): Syndactyly with fusion of toes two and three. Evidence: TAS. Frequency: Very rare (HP:0040284). (ORPHA:397941)
- Flat occiput (HP:0005469): Reduced convexity of the occiput (posterior part of skull). Evidence: TAS. Frequency: Very rare (HP:0040284). (ORPHA:397941)
- Periventricular heterotopia (HP:0007165): A form of gray matter heterotopia were the mislocalized gray matter is typically located periventricularly, also sometimes called subependymal heterotopia. Periventricular means beside the ventricles. This is by far the most common location for heterotopia. Subependymal heterotopia present in a wide array of variations. There can be a small single node or a large number of nodes, can exist on either or both sides of the brain at any point along the higher ventricle margins, can be small or large, single or multiple, and can form a small node or a large wavy or curved mass. Evidence: TAS. Frequency: Very rare (HP:0040284). (ORPHA:397941)
- Multiple cafe-au-lait spots (HP:0007565): The presence of six or more cafe-au-lait spots. Evidence: TAS. Frequency: Very rare (HP:0040284). (ORPHA:397941)
- Thick vermilion border (HP:0012471): Increased width of the skin of vermilion border region of upper lip. Evidence: TAS. Frequency: Very rare (HP:0040284). (ORPHA:397941)
- Eclabion (HP:0012472): A turning outward of the lip or lips, that is, eversion of the lips. Evidence: TAS. Frequency: Very rare (HP:0040284). (ORPHA:397941)